Phenotypes associated with the disease Intellectual disability-strabismus syndrome (ORPHA:363528):
- Strabismus (HP:0000486): A misalignment of the eyes so that the visual axes deviate from bifoveal fixation. The classification of strabismus may be based on a number of features including the relative position of the eyes, whether the deviation is latent or manifest, intermittent or constant, concomitant or otherwise and according to the age of onset and the relevance of any associated refractive error. Evidence: TAS. Frequency: Very frequent (HP:0040281). (ORPHA:363528)
- Intellectual disability (HP:0001249): The term intellectual disability or intellectual developmental disorder is used to describe significantly sub-average intellectual and adaptive functioning based on clinical assessment and as measured by individually administered, appropriately normed, standardized and validated tests of intellectual functioning and adaptive behavior, with onset during the developmental period from infancy through adolescence. Evidence: TAS. Frequency: Very frequent (HP:0040281). (ORPHA:363528)
- Failure to thrive (HP:0001508): Failure to thrive (FTT) refers to a child whose physical growth is substantially below the norm. Evidence: TAS. Frequency: Very frequent (HP:0040281). (ORPHA:363528)
- Microcephaly (HP:0000252): Head circumference below 2 standard deviations below the mean for age and gender. Evidence: TAS. Frequency: Frequent (HP:0040282). (ORPHA:363528)
- Epicanthus (HP:0000286): A fold of skin starting above the medial aspect of the upper eyelid and arching downward to cover, pass in front of and lateral to the medial canthus. Evidence: TAS. Frequency: Frequent (HP:0040282). (ORPHA:363528)
- Upslanted palpebral fissure (HP:0000582): The palpebral fissure inclination is more than two standard deviations above the mean for age (objective); or, the inclination of the palpebral fissure is greater than typical for age. Evidence: TAS. Frequency: Frequent (HP:0040282). (ORPHA:363528)
- Delayed speech and language development (HP:0000750): A degree of language development that is significantly below the norm for a child of a specified age. Evidence: TAS. Frequency: Frequent (HP:0040282). (ORPHA:363528)
- Spasticity (HP:0001257): A motor disorder characterized by a velocity-dependent increase in tonic stretch reflexes with increased muscle tone, exaggerated (hyperexcitable) tendon reflexes. Evidence: TAS. Frequency: Frequent (HP:0040282). (ORPHA:363528)
- Global developmental delay (HP:0001263): A delay in the achievement of motor or mental milestones in the domains of development of a child, including motor skills, speech and language, cognitive skills, and social and emotional skills. This term should only be used to describe children younger than five years of age. Evidence: TAS. Frequency: Frequent (HP:0040282). (ORPHA:363528)
- Short stature (HP:0004322): A height below that which is expected according to age and gender norms. Although there is no universally accepted definition of short stature, many refer to "short stature" as height more than 2 standard deviations below the mean for age and gender (or below the 3rd percentile for age and gender dependent norms). Evidence: TAS. Frequency: Frequent (HP:0040282). (ORPHA:363528)
- Depressed nasal bridge (HP:0005280): Posterior positioning of the nasal root in relation to the overall facial profile for age. Evidence: TAS. Frequency: Frequent (HP:0040282). (ORPHA:363528)
- Floppy infant (HP:0008947): Floppiness/hypotonia is defined as reduced resistance to passive movement of joints. Physical examination of floppy/hypotonic infants shows head lag, lack of shoulder and elbow muscle contraction on traction response, inability to tighten the shoulder girdle muscles (or slipping through) when held under the axillae, scarf sign (when the arm is pulled to the opposite side, the arm wraps around the neck with the elbow crossing midline), hyperdorsiflexion of the feet, easy apposition of the thumb against the forearm, feet touching the cheek with ease and without discomfort, frog leg position, and inverted U sign on ventral suspension (head, arms, and legs hanging down without elbow or knee flexion and the trunk rounded in a dome shape). Evidence: TAS. Frequency: Frequent (HP:0040282). (ORPHA:363528)
- Prominent forehead (HP:0011220): Forward prominence of the entire forehead, due to protrusion of the frontal bone. Evidence: TAS. Frequency: Frequent (HP:0040282). (ORPHA:363528)
- Abnormal brain morphology (HP:0012443): A structural abnormality of the brain, which has as its parts the forebrain, midbrain, and hindbrain. Evidence: TAS. Frequency: Frequent (HP:0040282). (ORPHA:363528)
- Cryptorchidism (HP:0000028): Testis in inguinal canal. That is, absence of one or both testes from the scrotum owing to failure of the testis or testes to descend through the inguinal canal to the scrotum. Evidence: TAS. Frequency: Occasional (HP:0040283). (ORPHA:363528)
- Hypospadias (HP:0000047): Abnormal position of urethral meatus on the ventral penile shaft (underside) characterized by displacement of the urethral meatus from the tip of the glans penis to the ventral surface of the penis, scrotum, or perineum. Evidence: TAS. Frequency: Occasional (HP:0040283). (ORPHA:363528)
- Micropenis (HP:0000054): Abnormally small penis. At birth, the normal penis is about 3 cm (stretched length from pubic tubercle to tip of penis) with micropenis less than 2.0-2.5 cm. Evidence: TAS. Frequency: Occasional (HP:0040283). (ORPHA:363528)
- Wide mouth (HP:0000154): Distance between the oral commissures more than 2 SD above the mean. Alternatively, an apparently increased width of the oral aperture (subjective). Evidence: TAS. Frequency: Occasional (HP:0040283). (ORPHA:363528)
- High palate (HP:0000218): Height of the palate more than 2 SD above the mean (objective) or palatal height at the level of the first permanent molar more than twice the height of the teeth (subjective). Evidence: TAS. Frequency: Occasional (HP:0040283). (ORPHA:363528)
- Long face (HP:0000276): Facial height (length) is more than 2 standard deviations above the mean (objective); or, an apparent increase in the height (length) of the face (subjective). Evidence: TAS. Frequency: Occasional (HP:0040283). (ORPHA:363528)
- Hypertelorism (HP:0000316): Interpupillary distance more than 2 SD above the mean (alternatively, the appearance of an increased interpupillary distance or widely spaced eyes). Evidence: TAS. Frequency: Occasional (HP:0040283). (ORPHA:363528)
- Facial asymmetry (HP:0000324): An abnormal difference between the left and right sides of the face. Evidence: TAS. Frequency: Occasional (HP:0040283). (ORPHA:363528)
- Sloping forehead (HP:0000340): Inclination of the anterior surface of the forehead from the vertical more than two standard deviations above the mean (objective); or apparently excessive posterior sloping of the forehead in a lateral view. Evidence: TAS. Frequency: Occasional (HP:0040283). (ORPHA:363528)
- Micrognathia (HP:0000347): Developmental hypoplasia of the mandible. Evidence: TAS. Frequency: Occasional (HP:0040283). (ORPHA:363528)
- High forehead (HP:0000348): An abnormally increased height of the forehead. Evidence: TAS. Frequency: Occasional (HP:0040283). (ORPHA:363528)
- Hearing impairment (HP:0000365): A decreased magnitude of the sensory perception of sound. Evidence: TAS. Frequency: Occasional (HP:0040283). (ORPHA:363528)
- Low-set ears (HP:0000369): Upper insertion of the ear to the scalp below an imaginary horizontal line drawn between the inner canthi of the eye and extending posteriorly to the ear. Evidence: TAS. Frequency: Occasional (HP:0040283). (ORPHA:363528)
- Macrotia (HP:0000400): Median longitudinal ear length greater than two standard deviations above the mean and median ear width greater than two standard deviations above the mean (objective); or, apparent increase in length and width of the pinna (subjective). Evidence: TAS. Frequency: Occasional (HP:0040283). (ORPHA:363528)
- Recurrent otitis media (HP:0000403): Increased susceptibility to otitis media, as manifested by recurrent episodes of otitis media. Evidence: TAS. Frequency: Occasional (HP:0040283). (ORPHA:363528)
- Narrow nasal ridge (HP:0000418): Decreased width of the nasal ridge. Evidence: TAS. Frequency: Occasional (HP:0040283). (ORPHA:363528)
- Prominent nose (HP:0000448): Distance between subnasale and pronasale more than two standard deviations above the mean, or alternatively, an apparently increased anterior protrusion of the nasal tip. Evidence: TAS. Frequency: Occasional (HP:0040283). (ORPHA:363528)
- Short neck (HP:0000470): Diminished length of the neck. Evidence: TAS. Frequency: Occasional (HP:0040283). (ORPHA:363528)
- Telecanthus (HP:0000506): Distance between the inner canthi more than two standard deviations above the mean (objective); or, apparently increased distance between the inner canthi. Evidence: TAS. Frequency: Occasional (HP:0040283). (ORPHA:363528)
- Synophrys (HP:0000664): Meeting of the medial eyebrows in the midline. Evidence: TAS. Frequency: Occasional (HP:0040283). (ORPHA:363528)
- Aggressive behavior (HP:0000718): Behavior or an act aimed at harming a person, animal, or physical property (e.g., acts of physical violence; shouting, swearing, and using harsh language; slashing someone's tires). Evidence: TAS. Frequency: Occasional (HP:0040283). (ORPHA:363528)
- Hyperactivity (HP:0000752): Hyperactivity is a condition characterized by constant and unusually high levels of activity, even in situations where it is deemed inappropriate. Evidence: TAS. Frequency: Occasional (HP:0040283). (ORPHA:363528)
- Decreased response to growth hormone stimulation test (HP:0000824): Insufficient responses to growth hormone (GH) provocation tests. GH deficiency is defined as a serum peak GH concentration less than 10 ng/mL on provocation with a combination of at least two separate stimulation tests. Evidence: TAS. Frequency: Occasional (HP:0040283). (ORPHA:363528)
- Hypohidrosis (HP:0000966): Abnormally diminished capacity to sweat. Evidence: TAS. Frequency: Occasional (HP:0040283). (ORPHA:363528)
- Seizure (HP:0001250): A seizure is an intermittent abnormality of nervous system physiology characterized by a transient occurrence of signs and/or symptoms due to abnormal excessive or synchronous neuronal activity in the brain. Evidence: TAS. Frequency: Occasional (HP:0040283). (ORPHA:363528)
- Plagiocephaly (HP:0001357): Asymmetric head shape, which is usually a combination of unilateral occipital flattening with ipsilateral frontal prominence, leading to rhomboid cranial shape. Evidence: TAS. Frequency: Occasional (HP:0040283). (ORPHA:363528)
- Limitation of joint mobility (HP:0001376): A reduction in the freedom of movement of one or more joints. Evidence: TAS. Frequency: Occasional (HP:0040283). (ORPHA:363528)
- Intrauterine growth retardation (HP:0001511): An abnormal restriction of fetal growth with fetal weight below the tenth percentile for gestational age. Evidence: TAS. Frequency: Occasional (HP:0040283). (ORPHA:363528)
- Polyhydramnios (HP:0001561): The presence of excess amniotic fluid in the uterus during pregnancy. Evidence: TAS. Frequency: Occasional (HP:0040283). (ORPHA:363528)
- Atrial septal defect (HP:0001631): Atrial septal defect (ASD) is a congenital abnormality of the interatrial septum that enables blood flow between the left and right atria via the interatrial septum. Evidence: TAS. Frequency: Occasional (HP:0040283). (ORPHA:363528)
- Patent ductus arteriosus (HP:0001643): In utero, the ductus arteriosus (DA) serves to divert ventricular output away from the lungs and toward the placenta by connecting the main pulmonary artery to the descending aorta. A patent ductus arteriosus (PDA) in the first 3 days of life is a physiologic shunt in healthy term and preterm newborn infants, and normally is substantially closed within about 24 hours after bith and completely closed after about three weeks. Failure of physiologcal closure is referred to a persistent or patent ductus arteriosus (PDA). Depending on the degree of left-to-right shunting, PDA can have clinical consequences. Evidence: TAS. Frequency: Occasional (HP:0040283). (ORPHA:363528)
- Talipes equinovarus (HP:0001762): Talipes equinovarus (also called clubfoot) typically has four main components: inversion and adduction of the forefoot; inversion of the heel and hindfoot; equinus (limitation of extension) of the ankle and subtalar joint; and internal rotation of the leg. Evidence: TAS. Frequency: Occasional (HP:0040283). (ORPHA:363528)
- Achilles tendon contracture (HP:0001771): A contracture of the Achilles tendon. Evidence: TAS. Frequency: Occasional (HP:0040283). (ORPHA:363528)
- Rocker bottom foot (HP:0001838): The presence of both a prominent heel and a convex contour of the sole. Evidence: TAS. Frequency: Occasional (HP:0040283). (ORPHA:363528)
- Gastroesophageal reflux (HP:0002020): A condition in which the stomach contents leak backwards from the stomach into the esophagus through the lower esophageal sphincter. Evidence: TAS. Frequency: Occasional (HP:0040283). (ORPHA:363528)
- Highly arched eyebrow (HP:0002553): Increased height of the central portion of the eyebrow, forming a crescent, semicircular, or inverted U shape. Evidence: TAS. Frequency: Occasional (HP:0040283). (ORPHA:363528)
- Short nose (HP:0003196): Distance from nasion to subnasale more than two standard deviations below the mean, or alternatively, an apparently decreased length from the nasal root to the nasal tip. Evidence: TAS. Frequency: Occasional (HP:0040283). (ORPHA:363528)
- Diffuse demyelination of the cerebral white matter (HP:0007162): A diffuse loss of myelin from nerve fibers in the central nervous system. Evidence: TAS. Frequency: Occasional (HP:0040283). (ORPHA:363528)
- Medullary nephrocalcinosis (HP:0012408): The deposition of calcium salts in the parenchyma of the renal medulla (innermost part of the kidney). Evidence: TAS. Frequency: Occasional (HP:0040283). (ORPHA:363528)
- Brain atrophy (HP:0012444): Partial or complete wasting (loss) of brain tissue that was once present. Evidence: TAS. Frequency: Occasional (HP:0040283). (ORPHA:363528)
- Delayed myelination (HP:0012448): Delayed myelination. Evidence: TAS. Frequency: Occasional (HP:0040283). (ORPHA:363528)
- Thick vermilion border (HP:0012471): Increased width of the skin of vermilion border region of upper lip. Evidence: TAS. Frequency: Occasional (HP:0040283). (ORPHA:363528)
- Decreased circulating insulin-like growth factor 1 concentration (HP:0030353): The concentration of insulin-like growth factor 1 (IGF1) in the blood circulation is below the lower limit of normal. Evidence: TAS. Frequency: Occasional (HP:0040283). (ORPHA:363528)
- Recurrent gastroenteritis (HP:0031123): Increased susceptibility to gastroenteritis, an infectious inflammationof the stomach and small intestines manifested by signs and symptoms such as diarheas and abdominal pain, as manifested by recurrent episodes of gastroenteritis. Evidence: TAS. Frequency: Occasional (HP:0040283). (ORPHA:363528)
- Impulsivity (HP:0100710): Acting on the spur of the moment or on a momentary basis without consideration of outcomes; having difficulty establishing or following plans; experiencing a sense of urgency and engaging in behavior that is uninhibited, cannot be inhibited, and is uncontrolled. The possibility of repression is inconceivable. Evidence: TAS. Frequency: Occasional (HP:0040283). (ORPHA:363528)
- Abnormality of the dentition (HP:0000164): Any abnormality of the teeth. Evidence: TAS. Frequency: Very rare (HP:0040284). (ORPHA:363528)
- Congenital diaphragmatic hernia (HP:0000776): The presence of a hernia of the diaphragm present at birth. Evidence: TAS. Frequency: Very rare (HP:0040284). (ORPHA:363528)
- Hypothyroidism (HP:0000821): Deficiency of thyroid hormone. Evidence: TAS. Frequency: Very rare (HP:0040284). (ORPHA:363528)
- Agenesis of corpus callosum (HP:0001274): Absence of the corpus callosum as a result of the failure of the corpus callosum to develop, which can be the result of a failure in any one of the multiple steps of callosal development including cellular proliferation and migration, axonal growth or glial patterning at the midline. Evidence: TAS. Frequency: Very rare (HP:0040284). (ORPHA:363528)
- Gait disturbance (HP:0001288): The term gait disturbance can refer to any disruption of the ability to walk. Evidence: TAS. Frequency: Very rare (HP:0040284). (ORPHA:363528)
- Hypoplasia of the corpus callosum (HP:0002079): Underdevelopment of the corpus callosum. Evidence: TAS. Frequency: Very rare (HP:0040284). (ORPHA:363528)
- Postural instability (HP:0002172): A tendency to fall or the inability to keep oneself from falling; imbalance. The retropulsion test is widely regarded as the gold standard to evaluate postural instability, Use of the retropulsion test includes a rapid balance perturbation in the backward direction, and the number of balance correcting steps (or total absence thereof) is used to rate the degree of postural instability. Healthy subjects correct such perturbations with either one or two large steps, or without taking any steps, hinging rapidly at the hips while swinging the arms forward as a counterweight. In patients with balance impairment, balance correcting steps are often too small, forcing patients to take more than two steps. Taking three or more steps is generally considered to be abnormal, and taking more than five steps is regarded as being clearly abnormal. Markedly affected patients continue to step backward without ever regaining their balance and must be caught by the examiner (this would be called true retropulsion). Even more severely affected patients fail to correct entirely, and fall backward like a pushed toy soldier, without taking any corrective steps. Evidence: TAS. Frequency: Very rare (HP:0040284). (ORPHA:363528)
- Congenital finger flexion contractures (HP:0005879): Multiple bent (flexed) finger joints that cannot be straightened actively or passively. Evidence: TAS. Frequency: Very rare (HP:0040284). (ORPHA:363528)
- Joint contracture of the hand (HP:0009473): Contractures of one ore more joints of the hands meaning chronic loss of joint motion due to structural changes in non-bony tissue. Evidence: TAS. Frequency: Very rare (HP:0040284). (ORPHA:363528)
- Peripheral neuropathy (HP:0009830): Peripheral neuropathy is a general term for any disorder of the peripheral nervous system. The main clinical features used to classify peripheral neuropathy are distribution, type (mainly demyelinating versus mainly axonal), duration, and course. Evidence: TAS. Frequency: Very rare (HP:0040284). (ORPHA:363528)
- Feeding difficulties (HP:0011968): Impaired ability to eat related to problems gathering food and getting ready to suck, chew, or swallow it. Evidence: TAS. Frequency: Very rare (HP:0040284). (ORPHA:363528)
- Chronic constipation (HP:0012450): Constipation for longer than three months with fewer than 3 bowel movements per week, straining, lumpy or hard stools, and a sensation of anorectal obstruction or incomplete defecation. Evidence: TAS. Frequency: Very rare (HP:0040284). (ORPHA:363528)
- Arachnoid cyst (HP:0100702): An extra-parenchymal and intra-arachnoidal collection of fluid with a composition similar to that of cerebrospinal fluid. Evidence: TAS. Frequency: Very rare (HP:0040284). (ORPHA:363528)